Phenotypes associated with the disease Oguchi disease-1 (OMIM:258100):
- Autosomal recessive inheritance (HP:0000007): A mode of inheritance that is observed for traits related to a gene encoded on one of the autosomes (i.e., the human chromosomes 1-22) in which a trait manifests in individuals with two pathogenic alleles, either homozygotes (two copies of the same mutant allele) or compound heterozygotes (whereby each copy of a gene has a distinct mutant allele). Evidence: PCS. (PMID:7670478)
- Early-onset non-progressive night blindness (HP:0007642): A usually nonprogressive (i.e., stationary) form of night blindness with early (presumed to be congenital) onset. Evidence: PCS. Frequency: 6/6. (PMID:7670478)
- Mizuo phenomenon (HP:0030824): Change in the color of the fundus from red in the dark-adapted state to golden immediately or shortly after the onset of the light. The color of the fundus reflex in the light adapted state has also been described as golden-yellow, gray-white, and yellow-white. This reflex can appear either homogeneous or in streaks in the fundus. The retinal vessels appear to be protruding in contrast to the radiant background. Dark adaptation leads to disappearance of the unusual fundus coloration [Digital Journal of Ophthalmology 2008; Volume 14, Number 14]. Evidence: PCS. Frequency: 6/6. (PMID:7670478)